Phenotypes associated with the disease Adenohypophysitis (ORPHA:95512):
- Panhypopituitarism (HP:0000871): A pituitary functional deficit affecting all the anterior pituitary hormones (growth hormone, thyroid-stimulating hormone, follicle-stimulating hormone, luteinizing hormone, adrenocorticotropic hormone, and prolactin). Evidence: TAS. Frequency: Very frequent (HP:0040281). (ORPHA:95512)
- Amenorrhea (HP:0000141): Absence of menses for an interval of time equivalent to a total of more than (or equal to) 3 previous cycles or 6 months. Evidence: TAS. Frequency: Frequent (HP:0040282). (ORPHA:95512)
- Blurred vision (HP:0000622): Lack of sharpness of vision resulting in the inability to see fine detail. Evidence: TAS. Frequency: Frequent (HP:0040282). (ORPHA:95512)
- Impotence (HP:0000802): Inability to develop or maintain an erection of the penis. Evidence: TAS. Frequency: Frequent (HP:0040282). (ORPHA:95512)
- Increased circulating prolactin concentration (HP:0000870): The presence of abnormally increased levels of prolactin in the blood. Prolactin is a peptide hormone produced by the anterior pituitary gland that plays a role in breast development and lactation during pregnancy. Evidence: TAS. Frequency: Frequent (HP:0040282). (ORPHA:95512)
- Pallor (HP:0000980): Abnormally pale skin. Evidence: TAS. Frequency: Frequent (HP:0040282). (ORPHA:95512)
- Orthostatic hypotension (HP:0001278): A form of hypotension characterized by a sudden fall in blood pressure that occurs when a person assumes a standing position. Evidence: TAS. Frequency: Frequent (HP:0040282). (ORPHA:95512)
- Normochromic anemia (HP:0001895). Evidence: TAS. Frequency: Frequent (HP:0040282). (ORPHA:95512)
- Nausea (HP:0002018): A sensation of unease in the stomach together with an urge to vomit. Evidence: TAS. Frequency: Frequent (HP:0040282). (ORPHA:95512)
- Headache (HP:0002315): Cephalgia, or pain sensed in various parts of the head, not confined to the area of distribution of any nerve. Evidence: TAS. Frequency: Frequent (HP:0040282). (ORPHA:95512)
- Hyposthenuria (HP:0003158): An abnormally low urinary specific gravity, i.e., reduced concentration of solutes in the urine. Evidence: TAS. Frequency: Frequent (HP:0040282). (ORPHA:95512)
- Progressive visual field defects (HP:0007987). Evidence: TAS. Frequency: Frequent (HP:0040282). (ORPHA:95512)
- Decreased circulating cortisol level (HP:0008163): Abnormally reduced concentration of cortisol in the blood. Evidence: TAS. Frequency: Frequent (HP:0040282). (ORPHA:95512)
- Gonadotropin deficiency (HP:0008213): A reduced ability to secrete gonadotropins, which are protein hormones secreted by gonadotrope cells of the anterior pituitary gland, including the hormones follitropin (FSH) and luteinizing hormone (LH). Evidence: TAS. Frequency: Frequent (HP:0040282). (ORPHA:95512)
- Decreased serum estradiol (HP:0008214): A reduction below normal concentration of estradiol in the circulation. Evidence: TAS. Frequency: Frequent (HP:0040282). (ORPHA:95512)
- Secondary growth hormone deficiency (HP:0008240). Evidence: TAS. Frequency: Frequent (HP:0040282). (ORPHA:95512)
- Pituitary hypothyroidism (HP:0008245): A type of hypothyroidism that results from a defect in thyroid-stimulating hormone secretion. Evidence: TAS. Frequency: Frequent (HP:0040282). (ORPHA:95512)
- Adrenocorticotropin deficient adrenal insufficiency (HP:0011735): Adrenal insufficiency secondary to a defect in ACTH production. Evidence: TAS. Frequency: Frequent (HP:0040282). (ORPHA:95512)
- Adrenocorticotropic hormone deficiency (HP:0011748): A reduced ability to secrete adrenocorticotropic hormone (ACTH), a hormone that stimulates the adrenal cortex to secrete of glucocorticoids such as cortisol. Evidence: TAS. Frequency: Frequent (HP:0040282). (ORPHA:95512)
- Abnormal size of pituitary gland (HP:0012504): A deviation from the normal size of the pituitary gland. Evidence: TAS. Frequency: Frequent (HP:0040282). (ORPHA:95512)
- Abnormal thalamic MRI signal intensity (HP:0012696): A deviation from normal signal on magnetic resonance imaging (MRI) of the thalamus. Evidence: TAS. Frequency: Frequent (HP:0040282). (ORPHA:95512)
- Decreased female libido (HP:0030018): Diminished sexual desire in female. Evidence: TAS. Frequency: Frequent (HP:0040282). (ORPHA:95512)
- Decreased serum testosterone concentration (HP:0040171). Evidence: TAS. Frequency: Frequent (HP:0040282). (ORPHA:95512)
- Decreased male libido (HP:0040306): Reduced desire for sexual activity on the part of a male. Evidence: TAS. Frequency: Frequent (HP:0040282). (ORPHA:95512)
- Sensorineural hearing impairment (HP:0000407): A type of hearing impairment in one or both ears related to an abnormal functionality of the cochlear nerve. Evidence: TAS. Frequency: Occasional (HP:0040283). (ORPHA:95512)
- Diplopia (HP:0000651): Diplopia is a condition in which a single object is perceived as two images, it is also known as double vision. Evidence: TAS. Frequency: Occasional (HP:0040283). (ORPHA:95512)
- Hashimoto thyroiditis (HP:0000872): A chronic, autoimmune type of thyroiditis associated with hypothyroidism. Evidence: TAS. Frequency: Occasional (HP:0040283). (ORPHA:95512)
- Hyponatremia (HP:0002902): The concentration of sodium in the blood circulation is below the lower limit of normal. Evidence: TAS. Frequency: Occasional (HP:0040283). (ORPHA:95512)
- Antinuclear antibody positivity (HP:0003493): The presence of autoantibodies in the serum that react against nuclei or nuclear components. Evidence: TAS. Frequency: Occasional (HP:0040283). (ORPHA:95512)
- Poor appetite (HP:0004396): A reduced desire to eat. Evidence: TAS. Frequency: Occasional (HP:0040283). (ORPHA:95512)
- Chronic lymphocytic meningitis (HP:0007041): Meningitis that persists for more than 4 weeks, and lymphocytes are present in the cerebrospinal fluid (CSF). Evidence: TAS. Frequency: Occasional (HP:0040283). (ORPHA:95512)
- Reduced circulating prolactin concentration (HP:0008202): A reduced level of prolactin in the blood circulation. Prolactin is a protein hormone that is secreted by lactotrophs in the anterior pituitary and that stimulates mammary gland development and milk production. Evidence: TAS. Frequency: Occasional (HP:0040283). (ORPHA:95512)